- High palate (HP:0000218): Height of the palate more than 2 SD above the mean (objective) or palatal height at the level of the first permanent molar more than twice the height of the teeth (subjective). Evidence: TAS. Frequency: Frequent (HP:0040282). (ORPHA:314575)
- Thin upper lip vermilion (HP:0000219): Height of the vermilion of the upper lip in the midline more than 2 SD below the mean. Alternatively, an apparently reduced height of the vermilion of the upper lip in the frontal view (subjective). Evidence: TAS. Frequency: Frequent (HP:0040282). (ORPHA:314575)
- Brachycephaly (HP:0000248): An abnormality of skull shape characterized by a decreased anterior-posterior diameter. That is, a cephalic index greater than 81%. Alternatively, an apparently shortened anteroposterior dimension (length) of the head compared to width. Evidence: TAS. Frequency: Frequent (HP:0040282). (ORPHA:314575)
- Low-set ears (HP:0000369): Upper insertion of the ear to the scalp below an imaginary horizontal line drawn between the inner canthi of the eye and extending posteriorly to the ear. Evidence: TAS. Frequency: Frequent (HP:0040282). (ORPHA:314575)
- Macrotia (HP:0000400): Median longitudinal ear length greater than two standard deviations above the mean and median ear width greater than two standard deviations above the mean (objective); or, apparent increase in length and width of the pinna (subjective). Evidence: TAS. Frequency: Frequent (HP:0040282). (ORPHA:314575)
- Downslanted palpebral fissures (HP:0000494): The palpebral fissure inclination is more than two standard deviations below the mean. Evidence: TAS. Frequency: Frequent (HP:0040282). (ORPHA:314575)
- Pectus excavatum (HP:0000767): A defect of the chest wall characterized by a depression of the sternum, giving the chest ("pectus") a caved-in ("excavatum") appearance. Evidence: TAS. Frequency: Frequent (HP:0040282). (ORPHA:314575)
- Craniosynostosis (HP:0001363): Craniosynostosis refers to the premature closure of the cranial sutures. Primary craniosynostosis refers to the closure of one or more sutures due to abnormalities in skull development, and secondary craniosynostosis results from failure of brain growth. Evidence: TAS. Frequency: Frequent (HP:0040282). (ORPHA:314575)
- Frontal bossing (HP:0002007): Bilateral bulging of the lateral frontal bone prominences with relative sparing of the midline. Evidence: TAS. Frequency: Frequent (HP:0040282). (ORPHA:314575)
- Pyloric stenosis (HP:0002021): Pyloric stenosis, also known as infantile hypertrophic pyloric stenosis, is an uncommon condition in infants characterized by abnormal thickening of the pylorus muscles in the stomach leading to gastric outlet obstruction. Clinically infants are well at birth. Then, at 3 to 6 weeks of age, the infants present with projectile vomiting, potentially leading to dehydration and weight loss. Evidence: TAS. Frequency: Frequent (HP:0040282). (ORPHA:314575)
- Short stature (HP:0004322): A height below that which is expected according to age and gender norms. Although there is no universally accepted definition of short stature, many refer to "short stature" as height more than 2 standard deviations below the mean for age and gender (or below the 3rd percentile for age and gender dependent norms). Evidence: TAS. Frequency: Frequent (HP:0040282). (ORPHA:314575)
- Depressed nasal bridge (HP:0005280): Posterior positioning of the nasal root in relation to the overall facial profile for age. Evidence: TAS. Frequency: Frequent (HP:0040282). (ORPHA:314575)
- Bilateral cryptorchidism (HP:0008689): Absence of both testes from the scrotum owing to failure of the testis or testes to descend through the inguinal canal to the scrotum. Evidence: TAS. Frequency: Frequent (HP:0040282). (ORPHA:314575)
- Floppy infant (HP:0008947): Floppiness/hypotonia is defined as reduced resistance to passive movement of joints. Physical examination of floppy/hypotonic infants shows head lag, lack of shoulder and elbow muscle contraction on traction response, inability to tighten the shoulder girdle muscles (or slipping through) when held under the axillae, scarf sign (when the arm is pulled to the opposite side, the arm wraps around the neck with the elbow crossing midline), hyperdorsiflexion of the feet, easy apposition of the thumb against the forearm, feet touching the cheek with ease and without discomfort, frog leg position, and inverted U sign on ventral suspension (head, arms, and legs hanging down without elbow or knee flexion and the trunk rounded in a dome shape). Evidence: TAS. Frequency: Frequent (HP:0040282). (ORPHA:314575)
These phenotypes are associated with the disease Intellectual disability-hypotonia-brachycephaly-pyloric stenosis-cryptorchidism syndrome (ORPHA:314575).